Phenotypes associated with the disease sick sinus syndrome 3, susceptibility to (OMIM:614090):
- Sick sinus syndrome (HP:0011704): An abnormality involving the generation of the action potential by the sinus node and is characterized by an atrial rate inappropriate for physiological requirements. Manifestations include severe sinus bradycardia, sinus pauses or arrest, sinus node exit block, chronic atrial tachyarrhythmias, alternating periods of atrial bradyarrhythmias and tachyarrhythmias, and inappropriate responses of heart rate during exercise or stress. Evidence: PCS. (PMID:21378987)